Phenotypes associated with the disease Urate-Binding globulin, decrease in (OMIM:191530):
- Abnormality of metabolism/homeostasis (HP:0001939). Evidence: IEA. (OMIM:191530)
- Autosomal dominant inheritance (HP:0000006): A mode of inheritance that is observed for traits related to a gene encoded on one of the autosomes (i.e., the human chromosomes 1-22) in which a trait manifests in heterozygotes. In the context of medical genetics, an autosomal dominant disorder is caused when a single copy of the mutant allele is present. Males and females are affected equally, and can both transmit the disorder with a risk of 50% for each child of inheriting the mutant allele. Evidence: IEA. (OMIM:191530)